Phenotypes associated with the disease Delayed speech-facial asymmetry-strabismus-ear lobe creases syndrome (ORPHA:3038):
- High palate (HP:0000218): Height of the palate more than 2 SD above the mean (objective) or palatal height at the level of the first permanent molar more than twice the height of the teeth (subjective). Evidence: TAS. Frequency: Frequent (HP:0040282). (ORPHA:3038)
- Hypertelorism (HP:0000316): Interpupillary distance more than 2 SD above the mean (alternatively, the appearance of an increased interpupillary distance or widely spaced eyes). Evidence: TAS. Frequency: Very frequent (HP:0040281). (ORPHA:3038)
- Facial asymmetry (HP:0000324): An abnormal difference between the left and right sides of the face. Evidence: TAS. Frequency: Very frequent (HP:0040281). (ORPHA:3038)
- Long philtrum (HP:0000343): Distance between nasal base and midline upper lip vermilion border more than 2 SD above the mean. Alternatively, an apparently increased distance between nasal base and midline upper lip vermilion border. Evidence: TAS. Frequency: Frequent (HP:0040282). (ORPHA:3038)
- Low-set ears (HP:0000369): Upper insertion of the ear to the scalp below an imaginary horizontal line drawn between the inner canthi of the eye and extending posteriorly to the ear. Evidence: TAS. Frequency: Very frequent (HP:0040281). (ORPHA:3038)
- Anteverted nares (HP:0000463): Anteriorly-facing nostrils viewed with the head in the Frankfurt horizontal and the eyes of the observer level with the eyes of the subject. This gives the appearance of an upturned nose (upturned nasal tip). Evidence: TAS. Frequency: Occasional (HP:0040283). (ORPHA:3038)
- Strabismus (HP:0000486): A misalignment of the eyes so that the visual axes deviate from bifoveal fixation. The classification of strabismus may be based on a number of features including the relative position of the eyes, whether the deviation is latent or manifest, intermittent or constant, concomitant or otherwise and according to the age of onset and the relevance of any associated refractive error. Evidence: TAS. Frequency: Very frequent (HP:0040281). (ORPHA:3038)
- Downslanted palpebral fissures (HP:0000494): The palpebral fissure inclination is more than two standard deviations below the mean. Evidence: TAS. Frequency: Frequent (HP:0040282). (ORPHA:3038)
- Ptosis (HP:0000508): The upper eyelid margin is positioned 3 mm or more lower than usual and covers the superior portion of the iris (objective); or, the upper lid margin obscures at least part of the pupil (subjective). Evidence: TAS. Frequency: Very frequent (HP:0040281). (ORPHA:3038)
- Exotropia (HP:0000577): A form of strabismus with one or both eyes deviated outward. Evidence: TAS. Frequency: Very frequent (HP:0040281). (ORPHA:3038)
- Delayed speech and language development (HP:0000750): A degree of language development that is significantly below the norm for a child of a specified age. Evidence: TAS. Frequency: Very frequent (HP:0040281). (ORPHA:3038)
- Intellectual disability (HP:0001249): The term intellectual disability or intellectual developmental disorder is used to describe significantly sub-average intellectual and adaptive functioning based on clinical assessment and as measured by individually administered, appropriately normed, standardized and validated tests of intellectual functioning and adaptive behavior, with onset during the developmental period from infancy through adolescence. Evidence: TAS. Frequency: Frequent (HP:0040282). (ORPHA:3038)
- Unilateral narrow palpebral fissure (HP:0007946): A fixed reduction in the vertical distance between the upper and lower eyelids with short palpebral fissures on one side only. Evidence: TAS. Frequency: Very frequent (HP:0040281). (ORPHA:3038)
- Anterior creases of earlobe (HP:0009908): Sharply demarcated, typically linear and approximately horizontal, indentations in the outer surface of the ear lobe. Evidence: TAS. Frequency: Very frequent (HP:0040281). (ORPHA:3038)